- Type I diabetes mellitus (HP:0100651): A chronic condition in which the pancreas produces little or no insulin. Type I diabetes mellitus is manifested by the sudden onset of severe hyperglycemia with rapid progression to diabetic ketoacidosis unless treated with insulin. Evidence: IEA. (PMID:9313763)
This phenotype is associated with the disease type 1 diabetes mellitus 20 (OMIM:612520).